Phenotypes associated with the disease X-linked intellectual disability, Stoll type (ORPHA:85326):
- Malar flattening (HP:0000272): Underdevelopment of the malar prominence of the jugal bone (zygomatic bone in mammals), appreciated in profile, frontal view, and/or by palpation. Evidence: TAS. Frequency: Frequent (HP:0040282). (ORPHA:85326)
- Hypertelorism (HP:0000316): Interpupillary distance more than 2 SD above the mean (alternatively, the appearance of an increased interpupillary distance or widely spaced eyes). Evidence: TAS. Frequency: Frequent (HP:0040282). (ORPHA:85326)
- Long philtrum (HP:0000343): Distance between nasal base and midline upper lip vermilion border more than 2 SD above the mean. Alternatively, an apparently increased distance between nasal base and midline upper lip vermilion border. Evidence: TAS. Frequency: Frequent (HP:0040282). (ORPHA:85326)
- Widow's peak (HP:0000349): Frontal hairline with bilateral arcs to a low point in the midline of the forehead. Evidence: TAS. Frequency: Frequent (HP:0040282). (ORPHA:85326)
- Broad nasal tip (HP:0000455): Increase in width of the nasal tip. Evidence: TAS. Frequency: Frequent (HP:0040282). (ORPHA:85326)
- Anteverted nares (HP:0000463): Anteriorly-facing nostrils viewed with the head in the Frankfurt horizontal and the eyes of the observer level with the eyes of the subject. This gives the appearance of an upturned nose (upturned nasal tip). Evidence: TAS. Frequency: Frequent (HP:0040282). (ORPHA:85326)
- Intellectual disability (HP:0001249): The term intellectual disability or intellectual developmental disorder is used to describe significantly sub-average intellectual and adaptive functioning based on clinical assessment and as measured by individually administered, appropriately normed, standardized and validated tests of intellectual functioning and adaptive behavior, with onset during the developmental period from infancy through adolescence. Evidence: TAS. Frequency: Frequent (HP:0040282). (ORPHA:85326)
- Large forehead (HP:0002003). Evidence: TAS. Frequency: Frequent (HP:0040282). (ORPHA:85326)
- Frontal bossing (HP:0002007): Bilateral bulging of the lateral frontal bone prominences with relative sparing of the midline. Evidence: TAS. Frequency: Frequent (HP:0040282). (ORPHA:85326)
- Clinodactyly of the 5th finger (HP:0004209): Clinodactyly refers to a bending or curvature of the fifth finger in the radial direction (i.e., towards the 4th finger). Evidence: TAS. Frequency: Frequent (HP:0040282). (ORPHA:85326)
- Short stature (HP:0004322): A height below that which is expected according to age and gender norms. Although there is no universally accepted definition of short stature, many refer to "short stature" as height more than 2 standard deviations below the mean for age and gender (or below the 3rd percentile for age and gender dependent norms). Evidence: TAS. Frequency: Frequent (HP:0040282). (ORPHA:85326)
- Hypoplastic nasal bridge (HP:0005281). Evidence: TAS. Frequency: Frequent (HP:0040282). (ORPHA:85326)